- Abnormal hair morphology (HP:0001595): An abnormality of the hair. Evidence: IEA. (OMIM:190340)
- Autosomal dominant inheritance (HP:0000006): A mode of inheritance that is observed for traits related to a gene encoded on one of the autosomes (i.e., the human chromosomes 1-22) in which a trait manifests in heterozygotes. In the context of medical genetics, an autosomal dominant disorder is caused when a single copy of the mutant allele is present. Males and females are affected equally, and can both transmit the disorder with a risk of 50% for each child of inheriting the mutant allele. Evidence: IEA. (OMIM:190340)
These phenotypes are associated with the disease familial multiple discoid fibromas (OMIM:190340).